Phenotypes associated with the disease trigonocephaly-short stature-developmental delay syndrome (OMIM:314320):
- Epicanthus (HP:0000286): A fold of skin starting above the medial aspect of the upper eyelid and arching downward to cover, pass in front of and lateral to the medial canthus. Evidence: IEA. (OMIM:314320)
- Narrow forehead (HP:0000341): Width of the forehead or distance between the frontotemporales is more than two standard deviations below the mean (objective); or apparently narrow intertemporal region (subjective). Evidence: IEA. (OMIM:314320)
- Broad alveolar ridges (HP:0000187). Evidence: TAS. (OMIM:314320)
- Wide nasal bridge (HP:0000431): Increased breadth of the nasal bridge (and with it, the nasal root). Evidence: IEA. (OMIM:314320)
- Inguinal hernia (HP:0000023): Protrusion of the contents of the abdominal cavity through the inguinal canal. Evidence: IEA. (OMIM:314320)
- Lambdoidal craniosynostosis (HP:0004443): A kind of craniosynostosis affecting the lambdoidal suture. Evidence: TAS. (OMIM:314320)
- Short stature (HP:0004322): A height below that which is expected according to age and gender norms. Although there is no universally accepted definition of short stature, many refer to "short stature" as height more than 2 standard deviations below the mean for age and gender (or below the 3rd percentile for age and gender dependent norms). Evidence: IEA. (OMIM:314320)
- Trigonocephaly (HP:0000243): Wedge-shaped, or triangular head, with the apex of the triangle at the midline of the forehead and the base of the triangle at the occiput. Evidence: IEA. Frequency: 2/2. (PMID:30797980)
- Sagittal craniosynostosis (HP:0004442): A kind of craniosynostosis affecting the sagittal suture. Evidence: TAS. (OMIM:314320)
- Seizure (HP:0001250): A seizure is an intermittent abnormality of nervous system physiology characterized by a transient occurrence of signs and/or symptoms due to abnormal excessive or synchronous neuronal activity in the brain. Evidence: IEA. (OMIM:314320)
- Global developmental delay (HP:0001263): A delay in the achievement of motor or mental milestones in the domains of development of a child, including motor skills, speech and language, cognitive skills, and social and emotional skills. This term should only be used to describe children younger than five years of age. Evidence: IEA. (OMIM:314320)
- Premature posterior fontanelle closure (HP:0005494). Evidence: IEA. (OMIM:314320)
- Ventricular septal defect (HP:0001629): A hole between the two bottom chambers (ventricles) of the heart. The defect is centered around the most superior aspect of the ventricular septum. Evidence: IEA. (OMIM:314320)
- Small for gestational age (HP:0001518): Smaller than normal size according to sex and gestational age related norms, defined as a weight below the 10th percentile for the gestational age. Evidence: IEA. (OMIM:314320)
- X-linked recessive inheritance (HP:0001419): A mode of inheritance that is observed for recessive traits related to a gene encoded on the X chromosome. In the context of medical genetics, X-linked recessive disorders manifest in males (who have one copy of the X chromosome and are thus hemizygotes), but generally not in female heterozygotes who have one mutant and one normal allele. Evidence: PCS. (PMID:30797980)
- Hypotelorism (HP:0000601): Interpupillary distance less than 2 SD below the mean (alternatively, the appearance of an decreased interpupillary distance or closely spaced eyes). Evidence: IEA. (OMIM:314320)
- Clinodactyly of the 5th finger (HP:0004209): Clinodactyly refers to a bending or curvature of the fifth finger in the radial direction (i.e., towards the 4th finger). Evidence: IEA. (OMIM:314320)
- High palate (HP:0000218): Height of the palate more than 2 SD above the mean (objective) or palatal height at the level of the first permanent molar more than twice the height of the teeth (subjective). Evidence: IEA. (OMIM:314320)
- Convex nasal ridge (HP:0000444): Nasal ridge curving anteriorly to an imaginary line that connects the nasal root and tip. The nose appears often also prominent, and the columella low. Evidence: IEA. (OMIM:314320)
- Intellectual disability (HP:0001249): The term intellectual disability or intellectual developmental disorder is used to describe significantly sub-average intellectual and adaptive functioning based on clinical assessment and as measured by individually administered, appropriately normed, standardized and validated tests of intellectual functioning and adaptive behavior, with onset during the developmental period from infancy through adolescence. Evidence: IEA. (OMIM:314320)
- Low-set ears (HP:0000369): Upper insertion of the ear to the scalp below an imaginary horizontal line drawn between the inner canthi of the eye and extending posteriorly to the ear. Evidence: IEA. (OMIM:314320)
- Posteriorly rotated ears (HP:0000358): A type of abnormal location of the ears in which the position of the ears is characterized by posterior rotation (the superior part of the ears is rotated towards the back of the head, and the inferior part of the ears towards the front). Evidence: IEA. (OMIM:314320)
- Small anterior fontanelle (HP:0000237): Abnormally decreased size of the anterior fontanelle with respect to age-dependent norms. Evidence: IEA. (OMIM:314320)